Phenotypes associated with the disease glycosylphosphatidylinositol biosynthesis defect 16 (OMIM:617816):
- Poor speech (HP:0002465). Evidence: PCS. Frequency: 3/3. (PMID:27694521)
- Delayed ability to walk (HP:0031936): A failure to achieve the ability to walk at an appropriate developmental stage. Most children learn to walk in a series of stages, and learn to walk short distances independently between 12 and 15 months. Evidence: PCS. Frequency: 3/3. (PMID:27694521)
- Seizure (HP:0001250): A seizure is an intermittent abnormality of nervous system physiology characterized by a transient occurrence of signs and/or symptoms due to abnormal excessive or synchronous neuronal activity in the brain. Evidence: PCS. Frequency: 3/3. Onset: Infantile onset (HP:0003593). (PMID:27694521)
- Elevated circulating alkaline phosphatase concentration (HP:0003155): Abnormally increased serum levels of alkaline phosphatase activity. Evidence: PCS. Frequency: 0/3. (PMID:27694521)
- Global developmental delay (HP:0001263): A delay in the achievement of motor or mental milestones in the domains of development of a child, including motor skills, speech and language, cognitive skills, and social and emotional skills. This term should only be used to describe children younger than five years of age. Evidence: PCS. Frequency: 3/3. (PMID:27694521)
- Infantile onset (HP:0003593): Onset of signs or symptoms of disease between 28 days to one year of life. Evidence: PCS. Frequency: 3/3. (PMID:27694521)
- Autosomal recessive inheritance (HP:0000007): A mode of inheritance that is observed for traits related to a gene encoded on one of the autosomes (i.e., the human chromosomes 1-22) in which a trait manifests in individuals with two pathogenic alleles, either homozygotes (two copies of the same mutant allele) or compound heterozygotes (whereby each copy of a gene has a distinct mutant allele). Evidence: PCS. (PMID:27694521)
- Intellectual disability (HP:0001249): The term intellectual disability or intellectual developmental disorder is used to describe significantly sub-average intellectual and adaptive functioning based on clinical assessment and as measured by individually administered, appropriately normed, standardized and validated tests of intellectual functioning and adaptive behavior, with onset during the developmental period from infancy through adolescence. Evidence: PCS. Frequency: 3/3. (PMID:27694521)